- Childhood onset (HP:0011463): Onset of disease at the age of between 1 and 5 years. Evidence: PCS. Frequency: 1/5. (PMID:29912901)
- Infantile onset (HP:0003593): Onset of signs or symptoms of disease between 28 days to one year of life. Evidence: PCS. Frequency: 4/5. (PMID:29912901)
- Nephroblastoma (HP:0002667): The presence of a nephroblastoma, which is a neoplasm of the kidney that primarily affects children. Evidence: PCS. Frequency: 5/5. (PMID:29912901)
- Autosomal dominant inheritance (HP:0000006): A mode of inheritance that is observed for traits related to a gene encoded on one of the autosomes (i.e., the human chromosomes 1-22) in which a trait manifests in heterozygotes. In the context of medical genetics, an autosomal dominant disorder is caused when a single copy of the mutant allele is present. Males and females are affected equally, and can both transmit the disorder with a risk of 50% for each child of inheriting the mutant allele. Evidence: PCS. (PMID:29912901)
These phenotypes are associated with the disease Wilms tumor 7 (OMIM:621332).